Phenotypes associated with the disease Lipodystrophy-intellectual disability-deafness syndrome (ORPHA:50811):
- Sensorineural hearing impairment (HP:0000407): A type of hearing impairment in one or both ears related to an abnormal functionality of the cochlear nerve. Evidence: TAS. Frequency: Very frequent (HP:0040281). (ORPHA:50811)
- Osteopenia (HP:0000938): Osteopenia is a term to define bone density that is not normal but also not as low as osteoporosis. By definition from the World Health Organization osteopenia is defined by bone densitometry as a T score -1 to -2.5. Evidence: TAS. Frequency: Very frequent (HP:0040281). (ORPHA:50811)
- Intellectual disability (HP:0001249): The term intellectual disability or intellectual developmental disorder is used to describe significantly sub-average intellectual and adaptive functioning based on clinical assessment and as measured by individually administered, appropriately normed, standardized and validated tests of intellectual functioning and adaptive behavior, with onset during the developmental period from infancy through adolescence. Evidence: TAS. Frequency: Very frequent (HP:0040281). (ORPHA:50811)
- Global developmental delay (HP:0001263): A delay in the achievement of motor or mental milestones in the domains of development of a child, including motor skills, speech and language, cognitive skills, and social and emotional skills. This term should only be used to describe children younger than five years of age. Evidence: TAS. Frequency: Very frequent (HP:0040281). (ORPHA:50811)
- Failure to thrive (HP:0001508): Failure to thrive (FTT) refers to a child whose physical growth is substantially below the norm. Evidence: TAS. Frequency: Very frequent (HP:0040281). (ORPHA:50811)
- Intrauterine growth retardation (HP:0001511): An abnormal restriction of fetal growth with fetal weight below the tenth percentile for gestational age. Evidence: TAS. Frequency: Very frequent (HP:0040281). (ORPHA:50811)
- Small for gestational age (HP:0001518): Smaller than normal size according to sex and gestational age related norms, defined as a weight below the 10th percentile for the gestational age. Evidence: TAS. Frequency: Very frequent (HP:0040281). (ORPHA:50811)
- Slender build (HP:0001533): Asthenic habitus refers to a slender build with long limbs, an angular profile, and prominent muscles or bones. Evidence: TAS. Frequency: Very frequent (HP:0040281). (ORPHA:50811)
- Short stature (HP:0004322): A height below that which is expected according to age and gender norms. Although there is no universally accepted definition of short stature, many refer to "short stature" as height more than 2 standard deviations below the mean for age and gender (or below the 3rd percentile for age and gender dependent norms). Evidence: TAS. Frequency: Very frequent (HP:0040281). (ORPHA:50811)
- Slender long bones with narrow diaphyses (HP:0004993): Reduced diameter of a long bone with a more pronounced reduction of the diameter of the diaphysis of the long bones. Evidence: TAS. Frequency: Very frequent (HP:0040281). (ORPHA:50811)
- Progeroid facial appearance (HP:0005328): A degree of wrinkling of the facial skin that is more than expected for the age of the individual, leading to a prematurely aged appearance. Evidence: TAS. Frequency: Very frequent (HP:0040281). (ORPHA:50811)
- Generalized lipodystrophy (HP:0009064): Generalized degenerative changes of the fat tissue. Evidence: TAS. Frequency: Very frequent (HP:0040281). (ORPHA:50811)
- Dense metaphyseal bands (HP:0100959): Dense radiopaque bands of bone which are thicker than the adjacent diaphyseal cortex and may form at the metaphysis of growing bones. They appear on radiographs as bone that is more radiopaque that the adjacent diaphyseal cortex. Evidence: TAS. Frequency: Very frequent (HP:0040281). (ORPHA:50811)